Phenotypes associated with the disease Anal fistula (ORPHA:228113):
- Anoperineal fistula (HP:0005218): The presence of a fistula (abnormal tunnel) between the anal canal and the perineum. Evidence: TAS. Frequency: Very frequent (HP:0040281). (ORPHA:228113)
- Pruritus (HP:0000989): Pruritus is an itch or a sensation that makes a person want to scratch. This term refers to an abnormally increased disposition to experience pruritus. Evidence: TAS. Frequency: Frequent (HP:0040282). (ORPHA:228113)
- Cellulitis (HP:0100658): A bacterial infection and inflammation of the skin und subcutaneous tissues. Evidence: TAS. Frequency: Frequent (HP:0040282). (ORPHA:228113)
- Anal pain (HP:0500005): Pain in and around the anus or rectum (perianal region). Evidence: TAS. Frequency: Frequent (HP:0040282). (ORPHA:228113)
- Increased total leukocyte count (HP:0001974): An abnormal increase in the number of leukocytes in the blood. Evidence: TAS. Frequency: Occasional (HP:0040283). (ORPHA:228113)
- Fever (HP:0001945): Body temperature elevated above the normal range. Evidence: TAS. Frequency: Very rare (HP:0040284). (ORPHA:228113)
- Chills (HP:0025143): A sudden sensation of feeling cold. Evidence: TAS. Frequency: Very rare (HP:0040284). (ORPHA:228113)